Phenotypes associated with the disease Prader-Willi syndrome due to paternal deletion of 15q11q13 type 1 (DECIPHER:14):
- Hypotonia (HP:0001252): Hypotonia is an abnormally low muscle tone (the amount of tension or resistance to movement in a muscle). Even when relaxed, muscles have a continuous and passive partial contraction which provides some resistance to passive stretching. Hypotonia thus manifests as diminished resistance to passive stretching. Hypotonia is not the same as muscle weakness, although the two conditions can co-exist. Evidence: IEA. (DECIPHER:14)
- Feeding difficulties in infancy (HP:0008872): Impaired feeding performance of an infant as manifested by difficulties such as weak and ineffective sucking, brief bursts of sucking, and falling asleep during sucking. There may be difficulties with chewing or maintaining attention. Evidence: IEA. (DECIPHER:14)
- Truncal obesity (HP:0001956): Obesity located preferentially in the trunk of the body as opposed to the extremities. Evidence: IEA. (DECIPHER:14)
- Hypogonadism (HP:0000135): A decreased functionality of the gonad. Evidence: IEA. (DECIPHER:14)
- Intellectual disability (HP:0001249): The term intellectual disability or intellectual developmental disorder is used to describe significantly sub-average intellectual and adaptive functioning based on clinical assessment and as measured by individually administered, appropriately normed, standardized and validated tests of intellectual functioning and adaptive behavior, with onset during the developmental period from infancy through adolescence. Evidence: IEA. (DECIPHER:14)